- Hand polydactyly (HP:0001161): A kind of polydactyly characterized by the presence of a supernumerary finger or fingers. Evidence: TAS. Frequency: Very frequent (HP:0040281). (ORPHA:93405)
- Triphalangeal thumb (HP:0001199): A thumb with three phalanges in a single, proximo-distal axis. Thus, this term applies if the thumb has an accessory phalanx, leading to a digit like appearance of the thumb. Evidence: TAS. Frequency: Occasional (HP:0040283). (ORPHA:93405)
- Limitation of joint mobility (HP:0001376): A reduction in the freedom of movement of one or more joints. Evidence: TAS. Frequency: Occasional (HP:0040283). (ORPHA:93405)
- 6 metacarpals (HP:0001501). Evidence: TAS. Frequency: Frequent (HP:0040282). (ORPHA:93405)
- Toe syndactyly (HP:0001770): Webbing or fusion of the toes, involving soft parts only or including bone structure. Bony fusions are referred to as "bony" Syndactyly if the fusion occurs in a radio-ulnar axis. Fusions of bones of the toes in a proximo-distal axis are referred to as "Symphalangism". Evidence: TAS. Frequency: Frequent (HP:0040282). (ORPHA:93405)
- Foot polydactyly (HP:0001829): A kind of polydactyly characterized by the presence of a supernumerary toe or toes. Evidence: TAS. Frequency: Frequent (HP:0040282). (ORPHA:93405)
- Short tibia (HP:0005736): Underdevelopment (reduced size) of the tibia. Evidence: TAS. Frequency: Frequent (HP:0040282). (ORPHA:93405)
- 1-5 finger cutaneous syndactyly (HP:0010708): A soft tissue continuity in the anteroposterior axis between the thumb to the little finger that extends distally to at least the level of the proximal interphalangeal joints (complete syndactyly of all fingers of the hand). Evidence: TAS. Frequency: Very frequent (HP:0040281). (ORPHA:93405)
- Camptodactyly of finger (HP:0100490): The distal interphalangeal joint and/or the proximal interphalangeal joint of the fingers cannot be extended to 180 degrees by either active or passive extension. Evidence: TAS. Frequency: Very frequent (HP:0040281). (ORPHA:93405)
These phenotypes are associated with the disease Syndactyly type 4 (ORPHA:93405).